Phenotypes associated with the disease Distal limb deficiencies-micrognathia syndrome (ORPHA:1307):
- Posteriorly rotated ears (HP:0000358): A type of abnormal location of the ears in which the position of the ears is characterized by posterior rotation (the superior part of the ears is rotated towards the back of the head, and the inferior part of the ears towards the front). Evidence: TAS. Frequency: Very frequent (HP:0040281). (ORPHA:1307)
- Microretrognathia (HP:0000308): A form of developmental hypoplasia of the mandible in which the mandible is mislocalised posteriorly. Evidence: TAS. Frequency: Very frequent (HP:0040281). (ORPHA:1307)
- Hypoplasia of the maxilla (HP:0000327): Abnormally small dimension of the Maxilla. Usually creating a malocclusion or malalignment between the upper and lower teeth or resulting in a deficient amount of projection of the base of the nose and lower midface region. Evidence: TAS. Frequency: Very frequent (HP:0040281). (ORPHA:1307)
- Abnormality of chromosome segregation (HP:0002916): An abnormality of chromosome segregation. Evidence: TAS. Frequency: Very frequent (HP:0040281). (ORPHA:1307)
- Abnormality of the ankle (HP:0003028): An anomaly of the joint that connects the foot with the leg. Evidence: TAS. Frequency: Very frequent (HP:0040281). (ORPHA:1307)
- Abnormal metacarpal morphology (HP:0005916): Any abnormal shape or structure of the metacarpal bones. Evidence: TAS. Frequency: Very frequent (HP:0040281). (ORPHA:1307)
- Oligodactyly (HP:0012165): A developmental defect resulting in the presence of fewer than the normal number of digits. Evidence: TAS. Frequency: Very frequent (HP:0040281). (ORPHA:1307)
- Cryptorchidism (HP:0000028): Testis in inguinal canal. That is, absence of one or both testes from the scrotum owing to failure of the testis or testes to descend through the inguinal canal to the scrotum. Evidence: TAS. Frequency: Frequent (HP:0040282). (ORPHA:1307)
- Renal insufficiency (HP:0000083): A reduction in the level of performance of the kidneys in areas of function comprising the concentration of urine, removal of wastes, the maintenance of electrolyte balance, homeostasis of blood pressure, and calcium metabolism. Evidence: TAS. Frequency: Frequent (HP:0040282). (ORPHA:1307)
- Renal hypoplasia (HP:0000089): Hypoplasia of the kidney. Evidence: TAS. Frequency: Frequent (HP:0040282). (ORPHA:1307)
- Proteinuria (HP:0000093): Increased levels of protein in the urine. Evidence: TAS. Frequency: Frequent (HP:0040282). (ORPHA:1307)
- Narrow mouth (HP:0000160): Distance between the commissures of the mouth more than 2 SD below the mean. Alternatively, an apparently decreased width of the oral aperture (subjective). Evidence: TAS. Frequency: Frequent (HP:0040282). (ORPHA:1307)
- High palate (HP:0000218): Height of the palate more than 2 SD above the mean (objective) or palatal height at the level of the first permanent molar more than twice the height of the teeth (subjective). Evidence: TAS. Frequency: Frequent (HP:0040282). (ORPHA:1307)
- Conductive hearing impairment (HP:0000405): An abnormality of vibrational conductance of sound to the inner ear leading to impairment of sensory perception of sound. Evidence: TAS. Frequency: Frequent (HP:0040282). (ORPHA:1307)
- Myopia (HP:0000545): An abnormality of refraction characterized by the ability to see objects nearby clearly, while objects in the distance appear blurry. Evidence: TAS. Frequency: Frequent (HP:0040282). (ORPHA:1307)
- Moderate intellectual disability (HP:0002342): Moderate intellectual disability (ID) is defined as a type of ID characterized by moderately sub-average adaptive functioning and intellectual functioning, with an intelligence quotient (IQ) the range of 35-49. Evidence: TAS. Frequency: Frequent (HP:0040282). (ORPHA:1307)
- Abnormality of the wrist (HP:0003019): Abnormality of the wrist, the structure connecting the hand and the forearm. Evidence: TAS. Frequency: Frequent (HP:0040282). (ORPHA:1307)
- Aplasia/Hypoplasia of the radius (HP:0006501): A small/hypoplastic or absent/aplastic radius. Evidence: TAS. Frequency: Frequent (HP:0040282). (ORPHA:1307)
- Aplasia/Hypoplasia of the thumb (HP:0009601): Hypoplastic/small or absent thumb. Evidence: TAS. Frequency: Frequent (HP:0040282). (ORPHA:1307)
- Microglossia (HP:0000171): Decreased length and width of the tongue. Evidence: TAS. Frequency: Occasional (HP:0040283). (ORPHA:1307)
- Cleft palate (HP:0000175): Cleft palate is a developmental defect of the palate resulting from a failure of fusion of the palatine processes and manifesting as a separation of the roof of the mouth (soft and hard palate). Evidence: TAS. Frequency: Occasional (HP:0040283). (ORPHA:1307)
- Macrocephaly (HP:0000256): Occipitofrontal (head) circumference greater than 97th centile compared to appropriate, age matched, sex-matched normal standards. Alternatively, a apparently increased size of the cranium. Evidence: TAS. Frequency: Occasional (HP:0040283). (ORPHA:1307)
- Sensorineural hearing impairment (HP:0000407): A type of hearing impairment in one or both ears related to an abnormal functionality of the cochlear nerve. Evidence: TAS. Frequency: Occasional (HP:0040283). (ORPHA:1307)
- Prominent nasal bridge (HP:0000426): Anterior positioning of the nasal root in comparison to the usual positioning for age. Evidence: TAS. Frequency: Occasional (HP:0040283). (ORPHA:1307)
- Nystagmus (HP:0000639): Rhythmic, involuntary oscillations of one or both eyes related to abnormality in fixation, conjugate gaze, or vestibular mechanisms. Evidence: TAS. Frequency: Occasional (HP:0040283). (ORPHA:1307)
- Microdontia (HP:0000691): Decreased size of the teeth, which can be defined as a mesiodistal tooth diameter (width) more than 2 SD below mean. Alternatively, an apparently decreased maximum width of tooth. Evidence: TAS. Frequency: Occasional (HP:0040283). (ORPHA:1307)
- Split foot (HP:0001839): A condition in which middle parts of the foot (toes and metatarsals) are missing giving a cleft appearance. The severity is very variable ranging from slightly hypoplastic 3rd toe over absent 2nd or 3rd toes as far as oligo- or monodactyl feet. Evidence: TAS. Frequency: Occasional (HP:0040283). (ORPHA:1307)
- Short stature (HP:0004322): A height below that which is expected according to age and gender norms. Although there is no universally accepted definition of short stature, many refer to "short stature" as height more than 2 standard deviations below the mean for age and gender (or below the 3rd percentile for age and gender dependent norms). Evidence: TAS. Frequency: Occasional (HP:0040283). (ORPHA:1307)
- Tarsal synostosis (HP:0008368): Synostosis (bony fusion) involving one or more bones of the tarsus (calcaneus, talus, cuboid, navicular, cuneiiform bones). Evidence: TAS. Frequency: Occasional (HP:0040283). (ORPHA:1307)
- Abnormal morphology of ulna (HP:0040071): Any structural anomaly of the ulna, a bone of the forearm the extends from the elbow to the little finger. Evidence: TAS. Frequency: Occasional (HP:0040283). (ORPHA:1307)